Phenotypes associated with the disease autosomal dominant nonsyndromic hearing loss 49 (OMIM:608372):
- Juvenile onset (HP:0003621): Onset of signs or symptoms of disease between the age of 5 and 15 years. Evidence: IEA. (OMIM:608372)
- Sensorineural hearing impairment (HP:0000407): A type of hearing impairment in one or both ears related to an abnormal functionality of the cochlear nerve. Evidence: IEA. (OMIM:608372)
- Progressive hearing impairment (HP:0001730): A progressive form of hearing impairment. Evidence: IEA. (OMIM:608372)
- Autosomal dominant inheritance (HP:0000006): A mode of inheritance that is observed for traits related to a gene encoded on one of the autosomes (i.e., the human chromosomes 1-22) in which a trait manifests in heterozygotes. In the context of medical genetics, an autosomal dominant disorder is caused when a single copy of the mutant allele is present. Males and females are affected equally, and can both transmit the disorder with a risk of 50% for each child of inheriting the mutant allele. Evidence: IEA. (OMIM:608372)